- Congenital onset (HP:0003577): A phenotypic abnormality that is present at birth. Evidence: PCS. (PMID:31211835)
- Ptosis (HP:0000508): The upper eyelid margin is positioned 3 mm or more lower than usual and covers the superior portion of the iris (objective); or, the upper lid margin obscures at least part of the pupil (subjective). Evidence: PCS. Frequency: 4/5. Onset: Congenital onset (HP:0003577). (PMID:31211835)
- Oculomotor synkinesis (HP:0033851): Elevation of the upper eyelid on attempted downward gaze or adduction, adduction of the eye on attempted upward or downward gaze, and constriction of the pupil on attempted adduction. Evidence: PCS. Frequency: 3/5. (PMID:31211835)
- Autosomal recessive inheritance (HP:0000007): A mode of inheritance that is observed for traits related to a gene encoded on one of the autosomes (i.e., the human chromosomes 1-22) in which a trait manifests in individuals with two pathogenic alleles, either homozygotes (two copies of the same mutant allele) or compound heterozygotes (whereby each copy of a gene has a distinct mutant allele). Evidence: PCS. (PMID:31211835)
- Duane anomaly (HP:0009921): A condition associated with a limitation of the horizontal ocular movement with retraction of the globe and narrowing of the palpebral fissure on adduction. Evidence: PCS. Frequency: 1/5. (PMID:31211835)
These phenotypes are associated with the disease oculomotor-abducens synkinesis (OMIM:619215).